Phenotypes associated with the disease Anonychia-microcephaly syndrome (ORPHA:1094):
- Abnormality of the dentition (HP:0000164): Any abnormality of the teeth. Evidence: TAS. Frequency: Frequent (HP:0040282). (ORPHA:1094)
- Microcephaly (HP:0000252): Head circumference below 2 standard deviations below the mean for age and gender. Evidence: TAS. Frequency: Frequent (HP:0040282). (ORPHA:1094)
- Sloping forehead (HP:0000340): Inclination of the anterior surface of the forehead from the vertical more than two standard deviations above the mean (objective); or apparently excessive posterior sloping of the forehead in a lateral view. Evidence: TAS. Frequency: Occasional (HP:0040283). (ORPHA:1094)
- Carious teeth (HP:0000670): Caries is a multifactorial bacterial infection affecting the structure of the tooth. This term has been used to describe the presence of more than expected dental caries. Evidence: TAS. Frequency: Occasional (HP:0040283). (ORPHA:1094)
- Anonychia (HP:0001798): Aplasia of the nail. Evidence: TAS. Frequency: Very frequent (HP:0040281). (ORPHA:1094)
- Clinodactyly of the 5th finger (HP:0004209): Clinodactyly refers to a bending or curvature of the fifth finger in the radial direction (i.e., towards the 4th finger). Evidence: TAS. Frequency: Occasional (HP:0040283). (ORPHA:1094)
- Bilateral single transverse palmar creases (HP:0007598): The distal and proximal transverse palmar creases are merged into a single transverse palmar crease on both hands. Evidence: TAS. Frequency: Frequent (HP:0040282). (ORPHA:1094)
- Aplastic/hypoplastic toenail (HP:0010624): Absence or underdevelopment of the toenail. Evidence: TAS. Frequency: Very frequent (HP:0040281). (ORPHA:1094)